Phenotypes associated with the disease mitochondrial complex I deficiency, nuclear type 8 (OMIM:618230):
- Encephalopathy (HP:0001298): Encephalopathy is a term that means brain disease, damage, or malfunction. In general, encephalopathy is manifested by an altered mental state. Evidence: IEA. (OMIM:618230)
- Kyphoscoliosis (HP:0002751): An abnormal curvature of the spine in both a coronal (lateral) and sagittal (back-to-front) plane. Evidence: PCS. Frequency: 1/1. (PMID:14729820)
- Dysphagia (HP:0002015): Difficulty in swallowing. Evidence: IEA. (OMIM:618230)
- Juvenile onset (HP:0003621): Onset of signs or symptoms of disease between the age of 5 and 15 years. Evidence: PCS. Frequency: 1/1. (PMID:14729820)
- Dystonia (HP:0001332): An abnormally increased muscular tone that causes fixed abnormal postures. There is a slow, intermittent twisting motion that leads to exaggerated turning and posture of the extremities and trunk. Evidence: IEA. (OMIM:618230)
- Axial dystonia (HP:0002530): A type of dystonia that affects the midline muscles, i.e., the chest, abdominal, and back muscles. Evidence: PCS. Frequency: 1/1. (PMID:14729820)
- Stiff neck (HP:0025258): A sensation of tightness in the neck when attempting to move it, especially after a period of inactivity. Neck stiffness often involves soreness and difficulty moving the neck, especially when trying to turn the head to the side. Evidence: PCS. Frequency: 1/1. (PMID:14729820)
- Increased circulating lactate concentration (HP:0002151): Abnormally increased level of blood lactate (2-hydroxypropanoic acid). Lactate is produced from pyruvate by lactate dehydrogenase during normal metabolism. The terms lactate and lactic acid are often used interchangeably but lactate (the component measured in blood) is strictly a weak base whereas lactic acid is the corresponding acid. Lactic acidosis is often used clinically to describe elevated lactate but should be reserved for cases where there is a corresponding acidosis (pH below 7.35). Evidence: IEA. (OMIM:618230)
- Tetraparesis (HP:0002273): Weakness of all four limbs. Evidence: IEA. (OMIM:618230)
- Generalized hypotonia (HP:0001290): Generalized muscular hypotonia (abnormally low muscle tone). Evidence: IEA. (OMIM:618230)
- Increased CSF lactate (HP:0002490): Increased concentration of lactate in the cerebrospinal fluid. Evidence: PCS. Frequency: 1/1. (PMID:14729820)
- Respiratory insufficiency (HP:0002093). Evidence: IEA. (OMIM:618230)
- Decreased activity of mitochondrial complex I (HP:0011923): A reduction in the activity of the mitochondrial respiratory chain complex I, which is part of the electron transport chain in mitochondria. Evidence: PCS. Frequency: 1/1. (PMID:14729820)
- Autosomal recessive inheritance (HP:0000007): A mode of inheritance that is observed for traits related to a gene encoded on one of the autosomes (i.e., the human chromosomes 1-22) in which a trait manifests in individuals with two pathogenic alleles, either homozygotes (two copies of the same mutant allele) or compound heterozygotes (whereby each copy of a gene has a distinct mutant allele). Evidence: PCS. (PMID:14729820)
- Optic disc pallor (HP:0000543): A pale yellow discoloration of the optic disc (the area of the optic nerve head in the retina). The optic disc normally has a pinkish hue with a central yellowish depression. Evidence: PCS. Frequency: 1/1. (PMID:14729820)
- Pancreatitis (HP:0001733): The presence of inflammation in the pancreas. Evidence: IEA. (OMIM:618230)
- Lactic acidosis (HP:0003128): An abnormal buildup of lactic acid in the body, leading to acidification of the blood and other bodily fluids. Evidence: IEA. (OMIM:618230)